Phenotypes associated with the disease polydactyly-macrocephaly syndrome (OMIM:620712):
- Congenital onset (HP:0003577): A phenotypic abnormality that is present at birth. Evidence: PCS. Frequency: 3/3. (PMID:38141607)
- Postaxial hand polydactyly (HP:0001162): Supernumerary digits located at the ulnar side of the hand (that is, on the side with the fifth finger). Evidence: PCS. Frequency: 3/3. (PMID:38141607)
- Single umbilical artery (HP:0001195): Single umbilical artery (SUA) is the absence of one of the two umbilical arteries surrounding the fetal bladder and in the fetal umbilical cord. Evidence: PCS. Frequency: 1/3. (PMID:38141607)
- Global developmental delay (HP:0001263): A delay in the achievement of motor or mental milestones in the domains of development of a child, including motor skills, speech and language, cognitive skills, and social and emotional skills. This term should only be used to describe children younger than five years of age. Evidence: PCS. Frequency: 1/2. (PMID:38141607)
- Thoracic platyspondyly (HP:0004592): A flattened vertebral body shape with reduced distance between the vertebral endplates affecting the thoracic spine. Evidence: PCS. Frequency: 1/3. (PMID:38141607)
- Serous retinal detachment (HP:0012231): A type of retinal detachment such that fluid is present in the subretinal space and separate the neurosensory retina from the retinal pigment epithelium. It is not associated with a full-thickness break nor a tractional component. Due to breakdown of outer blood-retina barrier or increased exudation from abnormal vasculature or defective outflow. Evidence: PCS. Frequency: 1/2. (PMID:38141607)
- Cataract (HP:0000518): A cataract is an opacity or clouding that develops in the crystalline lens of the eye or in its capsule. Evidence: PCS. Frequency: 1/2. (PMID:38141607)
- Autistic behavior (HP:0000729): Persistent deficits in social interaction and communication and interaction as well as a markedly restricted repertoire of activity and interest as well as repetitive patterns of behavior. Evidence: PCS. Frequency: 2/2. (PMID:38141607)
- Microphthalmia (HP:0000568): A developmental anomaly characterized by abnormal smallness of one or both eyes. Evidence: PCS. Frequency: 1/2. (PMID:38141607)
- Ventriculomegaly (HP:0002119): An increase in size of the ventricular system of the brain. Evidence: PCS. Frequency: 1/3. (PMID:38141607)
- Pectus carinatum (HP:0000768): A deformity of the chest caused by overgrowth of the ribs and characterized by protrusion of the sternum. Evidence: PCS. Frequency: 1/3. (PMID:38141607)
- Postaxial foot polydactyly (HP:0001830): Polydactyly of the foot most commonly refers to the presence of six toes on one foot. Postaxial polydactyly affects the lateral ray and the duplication may range from a well-formed articulated digit to a rudimentary digit. Evidence: PCS. Frequency: 3/3. (PMID:38141607)
- Atrial septal defect (HP:0001631): Atrial septal defect (ASD) is a congenital abnormality of the interatrial septum that enables blood flow between the left and right atria via the interatrial septum. Evidence: PCS. Frequency: 1/1. (PMID:38141607)
- Hypospadias (HP:0000047): Abnormal position of urethral meatus on the ventral penile shaft (underside) characterized by displacement of the urethral meatus from the tip of the glans penis to the ventral surface of the penis, scrotum, or perineum. Evidence: PCS. Frequency: 1/3. (PMID:38141607)
- Macrocephaly (HP:0000256): Occipitofrontal (head) circumference greater than 97th centile compared to appropriate, age matched, sex-matched normal standards. Alternatively, a apparently increased size of the cranium. Evidence: PCS. Frequency: 2/3. (PMID:38141607)
- Perianal abscess (HP:0009789): The presence of an abscess located around the anus. Evidence: PCS. Frequency: 1/3. (PMID:38141607)
- Chorioretinal coloboma (HP:0000567): Absence of a region of the retina, retinal pigment epithelium, and choroid. Evidence: PCS. Frequency: 1/2. (PMID:38141607)
- Autosomal dominant inheritance (HP:0000006): A mode of inheritance that is observed for traits related to a gene encoded on one of the autosomes (i.e., the human chromosomes 1-22) in which a trait manifests in heterozygotes. In the context of medical genetics, an autosomal dominant disorder is caused when a single copy of the mutant allele is present. Males and females are affected equally, and can both transmit the disorder with a risk of 50% for each child of inheriting the mutant allele. Evidence: PCS. (PMID:38141607)
- Renal agenesis (HP:0000104): Agenesis, that is, failure of the kidney to develop during embryogenesis and development. Evidence: PCS. Frequency: 1/3. (PMID:38141607)
- Patent foramen ovale (HP:0001655): Failure of the foramen ovale to seal postnatally, leaving a potential conduit between the left and right cardiac atria. Evidence: PCS. Frequency: 1/3. (PMID:38141607)